- Wide mouth (HP:0000154): Distance between the oral commissures more than 2 SD above the mean. Alternatively, an apparently increased width of the oral aperture (subjective). Evidence: TAS. Frequency: Occasional (HP:0040283). (ORPHA:268940)
- Tongue muscle weakness (HP:0000183): Reduced strength of the tongue musculature, resulting in difficulties moving the tongue and possible accompanied by dysarthria or dysphagia. Evidence: TAS. Frequency: Occasional (HP:0040283). (ORPHA:268940)
- Macrocephaly (HP:0000256): Occipitofrontal (head) circumference greater than 97th centile compared to appropriate, age matched, sex-matched normal standards. Alternatively, a apparently increased size of the cranium. Evidence: TAS. Frequency: Occasional (HP:0040283). (ORPHA:268940)
- Micrognathia (HP:0000347): Developmental hypoplasia of the mandible. Evidence: TAS. Frequency: Occasional (HP:0040283). (ORPHA:268940)
- Low-set ears (HP:0000369): Upper insertion of the ear to the scalp below an imaginary horizontal line drawn between the inner canthi of the eye and extending posteriorly to the ear. Evidence: TAS. Frequency: Occasional (HP:0040283). (ORPHA:268940)
- Sensorineural hearing impairment (HP:0000407): A type of hearing impairment in one or both ears related to an abnormal functionality of the cochlear nerve. Evidence: TAS. Frequency: Occasional (HP:0040283). (ORPHA:268940)
- Dysarthria (HP:0001260): Dysarthric speech is a general description referring to a neurological speech disorder characterized by poor articulation. Depending on the involved neurological structures, dysarthria may be further classified as spastic, flaccid, ataxic, hyperkinetic and hypokinetic, or mixed. Evidence: TAS. Frequency: Occasional (HP:0040283). (ORPHA:268940)
- Facial diplegia (HP:0001349): Facial diplegia refers to bilateral facial palsy (bilateral facial palsy is much rarer than unilateral facial palsy). Evidence: TAS. Frequency: Occasional (HP:0040283). (ORPHA:268940)
- Talipes equinovarus (HP:0001762): Talipes equinovarus (also called clubfoot) typically has four main components: inversion and adduction of the forefoot; inversion of the heel and hindfoot; equinus (limitation of extension) of the ankle and subtalar joint; and internal rotation of the leg. Evidence: TAS. Frequency: Occasional (HP:0040283). (ORPHA:268940)
- Bilateral tonic-clonic seizure (HP:0002069): A bilateral tonic-clonic seizure is a seizure defined by a tonic (bilateral increased tone, lasting seconds to minutes) and then a clonic (bilateral sustained rhythmic jerking) phase. Evidence: TAS. Frequency: Occasional (HP:0040283). (ORPHA:268940)
- Generalized myoclonic seizure (HP:0002123): A generalized myoclonic seizure is a type of generalized motor seizure characterized by bilateral, sudden, brief (<100 ms) involuntary single or multiple contraction of muscles or muscle groups of variable topography (axial, proximal limb, distal). Myoclonus is less regularly repetitive and less sustained than is clonus. Evidence: TAS. Frequency: Occasional (HP:0040283). (ORPHA:268940)
- Generalized-onset seizure (HP:0002197): A generalized-onset seizure is a type of seizure originating at some point within, and rapidly engaging, bilaterally distributed networks. The networks may include cortical and subcortical structures but not necessarily the entire cortex. Evidence: TAS. Frequency: Occasional (HP:0040283). (ORPHA:268940)
- Drooling (HP:0002307): Habitual flow of saliva out of the mouth. Evidence: TAS. Frequency: Occasional (HP:0040283). (ORPHA:268940)
- Arthrogryposis multiplex congenita (HP:0002804): Multiple congenital contractures in different body areas. Evidence: TAS. Frequency: Occasional (HP:0040283). (ORPHA:268940)
- 4-layered lissencephaly (HP:0006818): A form of lissencephaly in which the cortex is thickened and has four more or less disorganized layers rather than six normal layers resulting from incomplete neuronal migration during brain development. At neuropathological examination, a 4-layered cortex consists of an upper molecular layer, a second thin cellular layer containing pyramidal neurons usually observed in layer V, a third pale poorly cellular layer and a fourth thick deep layer made up of neurons which had failed to migrate. Radiologocally would manifest as agyria or pachygyria with cortical thickness greater than 10 mm. Evidence: TAS. Frequency: Occasional (HP:0040283). (ORPHA:268940)
- Pseudobulbar paralysis (HP:0007024): Bilateral impairment of the function of the cranial nerves 9-12, which control musculature involved in eating, swallowing, and speech. Pseudobulbar paralysis is characterized clinically by dysarthria, dysphonia, and dysphagia with bifacial paralysis, and may be accompanied by Pseudobulbar behavioral symptoms such as enforced crying and laughing. Evidence: TAS. Frequency: Occasional (HP:0040283). (ORPHA:268940)
- Central hypothyroidism (HP:0011787): A type of hypothyroidism due to an insufficient stimulation of an otherwise normal thyroid gland. Central hypothyroidism is caused by either pituitary (secondary hypothyroidism) or hypothalamic (tertiary hypothyroidism) defects. Evidence: TAS. Frequency: Occasional (HP:0040283). (ORPHA:268940)
- Feeding difficulties (HP:0011968): Impaired ability to eat related to problems gathering food and getting ready to suck, chew, or swallow it. Evidence: TAS. Frequency: Occasional (HP:0040283). (ORPHA:268940)
- Infantile spasms (HP:0012469): Infantile spasms represent a subset of "epileptic spasms". Infantile Spasms are epileptic spasms starting in the first year of life (infancy). Evidence: TAS. Frequency: Occasional (HP:0040283). (ORPHA:268940)
- Perisylvian polymicrogyria (HP:0012650): Polymicrogyria (an excessive number of small gyri or convolutions) that is maximal in perisylvian regions (the regions that surround the Sylvian fissures), which may be symmetric or asymmetric and may extend beyond perisylvian regions. The Sylvian fissures often extend posteriorly and superiorly. Evidence: TAS. Frequency: Occasional (HP:0040283). (ORPHA:268940)
- Abnormality of masticatory muscle (HP:0410011): Any abnormality of the masticatory muscle. Evidence: TAS. Frequency: Occasional (HP:0040283). (ORPHA:268940)
- Abnormal glossopharyngeal nerve morphology (HP:3000047): Any structural anomaly of the glossopharyngeal nerve, the ninth paired cranial nerve (CN IX). Evidence: TAS. Frequency: Occasional (HP:0040283). (ORPHA:268940)
- Seizure (HP:0001250): A seizure is an intermittent abnormality of nervous system physiology characterized by a transient occurrence of signs and/or symptoms due to abnormal excessive or synchronous neuronal activity in the brain. Evidence: TAS. Frequency: Very frequent (HP:0040281). (ORPHA:268940)
- Esotropia (HP:0000565): A form of strabismus with one or both eyes turned inward ('crossed') to a relatively severe degree, usually defined as 10 diopters or more. Evidence: TAS. Frequency: Frequent (HP:0040282). (ORPHA:268940)
- Delayed speech and language development (HP:0000750): A degree of language development that is significantly below the norm for a child of a specified age. Evidence: TAS. Frequency: Frequent (HP:0040282). (ORPHA:268940)
- Mild intellectual disability (HP:0001256): Mild intellectual disability (ID) is defined as a type of ID characterized by mildly sub-average adaptive functioning and intellectual functioning, with an intelligence quotient (IQ) the range of 50-69. Evidence: TAS. Frequency: Frequent (HP:0040282). (ORPHA:268940)
- Global developmental delay (HP:0001263): A delay in the achievement of motor or mental milestones in the domains of development of a child, including motor skills, speech and language, cognitive skills, and social and emotional skills. This term should only be used to describe children younger than five years of age. Evidence: TAS. Frequency: Frequent (HP:0040282). (ORPHA:268940)
- Mental deterioration (HP:0001268): Loss of previously present mental abilities, generally in adults. Evidence: TAS. Frequency: Frequent (HP:0040282). (ORPHA:268940)
- Motor delay (HP:0001270): A type of Developmental delay characterized by a delay in acquiring motor skills. Evidence: TAS. Frequency: Frequent (HP:0040282). (ORPHA:268940)
- Cerebellar atrophy (HP:0001272): Cerebellar atrophy is defined as a cerebellum with initially normal structures, in a posterior fossa with normal size, which displays enlarged fissures (interfolial spaces) in comparison to the foliae secondary to loss of tissue. Cerebellar atrophy implies irreversible loss of tissue and result from an ongoing progressive disease until a final stage is reached or a single injury, e.g. an intoxication or infectious event. Evidence: TAS. Frequency: Frequent (HP:0040282). (ORPHA:268940)
- Spastic tetraparesis (HP:0001285): Spastic weakness affecting all four limbs. Evidence: TAS. Frequency: Frequent (HP:0040282). (ORPHA:268940)
- Ventriculomegaly (HP:0002119): An increase in size of the ventricular system of the brain. Evidence: TAS. Frequency: Frequent (HP:0040282). (ORPHA:268940)
- Pseudobulbar signs (HP:0002200): Pseudobulbar signs result from injury to an upper motor neuron lesion to the corticobulbar pathways in the pyramidal tract. Patients have difficulty chewing, swallowing and demonstrate slurred speech (often initial presentation) as well as abnormal behavioral symptoms such as inappropriate emotional outbursts of uncontrolled laughter or weeping etc. Evidence: TAS. Frequency: Frequent (HP:0040282). (ORPHA:268940)
- Moderate intellectual disability (HP:0002342): Moderate intellectual disability (ID) is defined as a type of ID characterized by moderately sub-average adaptive functioning and intellectual functioning, with an intelligence quotient (IQ) the range of 35-49. Evidence: TAS. Frequency: Frequent (HP:0040282). (ORPHA:268940)
- Language impairment (HP:0002463): Language impairment is a deficit in comprehension or production of language that includes reduced vocabulary, limited sentence structure, or impairments in written or spoken communication. Language abilities are substantially and quantifiably below age expectations. Evidence: TAS. Frequency: Frequent (HP:0040282). (ORPHA:268940)
- Functional motor deficit (HP:0004302). Evidence: TAS. Frequency: Frequent (HP:0040282). (ORPHA:268940)
- Abnormal pyramidal sign (HP:0007256): Functional neurological abnormalities related to dysfunction of the pyramidal tract. Evidence: TAS. Frequency: Frequent (HP:0040282). (ORPHA:268940)
- Focal-onset seizure (HP:0007359): A focal-onset seizure is a type of seizure originating within networks limited to one hemisphere. They may be discretely localized or more widely distributed, and may originate in subcortical structures. Evidence: TAS. Frequency: Frequent (HP:0040282). (ORPHA:268940)
- Aplasia/Hypoplasia of the brainstem (HP:0007362). Evidence: TAS. Frequency: Frequent (HP:0040282). (ORPHA:268940)
- Cerebellar ataxia associated with quadrupedal gait (HP:0009878): The presence of cerebellar signs and symptoms such as lack of balance associated with quadrupedal gait (locomotion on all four extremities with a 'bear-like' gait with the legs held straight). Evidence: TAS. Frequency: Frequent (HP:0040282). (ORPHA:268940)
- Dyslexia (HP:0010522): A learning disorder characterized primarily by difficulties in learning to read and spell. Dyslectic children also exhibit a tendency to read words from right to left and to confuse letters such as b and d whose orientation is important for their identification. Children with dyslexia appear to be impaired in phonemic skills (the ability to associate visual symbols with the sounds they represent). Evidence: TAS. Frequency: Frequent (HP:0040282). (ORPHA:268940)
- Spastic hemiparesis (HP:0011099): Unilateral paresis (weakness) with spasticity of the affected muscles and increased tendon reflexes. Evidence: TAS. Frequency: Frequent (HP:0040282). (ORPHA:268940)
- Aplasia/Hypoplasia of the cerebral white matter (HP:0012429): Absence or underdevelopment of the cerebral white matter. Evidence: TAS. Frequency: Frequent (HP:0040282). (ORPHA:268940)
- Cognitive impairment (HP:0100543): Abnormal cognition is characterized by deficits in thinking, reasoning, or remembering. Evidence: TAS. Frequency: Frequent (HP:0040282). (ORPHA:268940)
These phenotypes are associated with the disease Bilateral polymicrogyria (ORPHA:268940).